Phenotypes associated with the disease nanophthalmos 1 (OMIM:600165, an entry in Online Mendelian Inheritance in Man):
- Bilateral microphthalmos (HP:0007633, a Human Phenotype Ontology term): A developmental anomaly characterized by abnormal smallness of both eyes. Evidence: IEA. (OMIM:600165)
- Autosomal dominant inheritance (HP:0000006, a Human Phenotype Ontology term): A mode of inheritance that is observed for traits related to a gene encoded on one of the autosomes (i.e., the human chromosomes 1-22) in which a trait manifests in heterozygotes. In the context of medical genetics, an autosomal dominant disorder is caused when a single copy of the mutant allele is present. Males and females are affected equally, and can both transmit the disorder with a risk of 50% for each child of inheriting the mutant allele. Evidence: IEA. (OMIM:600165)